- Hyperpigmentation of the skin (HP:0000953): A darkening of the skin related to an increase in melanin production and deposition. Evidence: PCS. (PMID:16709486)
- Autosomal dominant inheritance (HP:0000006): A mode of inheritance that is observed for traits related to a gene encoded on one of the autosomes (i.e., the human chromosomes 1-22) in which a trait manifests in heterozygotes. In the context of medical genetics, an autosomal dominant disorder is caused when a single copy of the mutant allele is present. Males and females are affected equally, and can both transmit the disorder with a risk of 50% for each child of inheriting the mutant allele. Evidence: PCS. (PMID:16709486)
These phenotypes are associated with the disease familial progressive hyperpigmentation (OMIM:614233).